- Large forehead (HP:0002003). Evidence: PCS. (PMID:17632775)
- Decreased body weight (HP:0004325): Abnormally low body weight. Evidence: IEA. (OMIM:300321)
- Delayed speech and language development (HP:0000750): A degree of language development that is significantly below the norm for a child of a specified age. Evidence: PCS. (PMID:17632775)
- Broad hallux (HP:0010055): Visible increase in width of the hallux without an increase in the dorso-ventral dimension. Evidence: IEA. (OMIM:300321)
- Prominent forehead (HP:0011220): Forward prominence of the entire forehead, due to protrusion of the frontal bone. Evidence: IEA. (OMIM:300321)
- Underdeveloped superior crus of antihelix (HP:0011246): Decreased protrusion of the superior crus relative to the prominence of a normal antihelix stem. Evidence: PCS. (PMID:17632775)
- Neonatal hypotonia (HP:0001319): Muscular hypotonia (abnormally low muscle tone) manifesting in the neonatal period. Evidence: TAS. (PMID:17632775)
- X-linked inheritance (HP:0001417): A mode of inheritance that is observed for traits related to a gene encoded on the X chromosome. Evidence: PCS. (PMID:17632775)
- Protruding ear (HP:0000411): Angle formed by the plane of the ear and the mastoid bone greater than the 97th centile for age (objective); or, outer edge of the helix more than 2 cm from the mastoid at the point of maximum distance (objective). Evidence: IEA. (OMIM:300321)
- Constipation (HP:0002019): Infrequent or difficult evacuation of feces. Evidence: PCS. (PMID:17632775)
- Frontal upsweep of hair (HP:0002236): Upward and/or sideward growth of anterior hair. Evidence: IEA. (OMIM:300321)
These phenotypes are associated with the disease FG syndrome 2 (OMIM:300321).